- Visual hallucination (HP:0002367): Visual perception in the absence of a visual stimulus. Evidence: IEA. (OMIM:127750)
- Lewy bodies (HP:0100315). Evidence: IEA. (OMIM:127750)
- Parkinsonism (HP:0001300): Characteristic neurologic anomaly resulting from degeneration of dopamine-generating cells in the substantia nigra, a region of the midbrain, characterized clinically by shaking, rigidity, slowness of movement and difficulty with walking and gait. Evidence: IEA. (OMIM:127750)
- Dementia (HP:0000726): A loss of global cognitive ability of sufficient amount to interfere with normal social or occupational function. Dementia represents a loss of previously present cognitive abilities, generally in adults, and can affect memory, thinking, language, judgment, and behavior. Evidence: IEA. (OMIM:127750)
- Delusion (HP:0000746): A delusion is a fixed false belief held despite evidence to the contrary. The term delusion broadly encompasses all false judgments that possess the following external characteristics to a significant, albeit unspecified, extent: (1) they are held with an exceptional level of conviction, accompanied by an unparalleled subjective certainty; (2) there is an inability to consider alternative experiences or compelling counter-arguments; (3) the content of the belief is impossible. Evidence: IEA. (OMIM:127750)
- Fluctuations in consciousness (HP:0007159): Changes in one's level of awareness and responsiveness to their environment. Evidence: IEA. (OMIM:127750)
- Autosomal dominant inheritance (HP:0000006): A mode of inheritance that is observed for traits related to a gene encoded on one of the autosomes (i.e., the human chromosomes 1-22) in which a trait manifests in heterozygotes. In the context of medical genetics, an autosomal dominant disorder is caused when a single copy of the mutant allele is present. Males and females are affected equally, and can both transmit the disorder with a risk of 50% for each child of inheriting the mutant allele. Evidence: IEA. (OMIM:127750)
These phenotypes are associated with the disease Lewy body dementia (OMIM:127750).